- Microcephaly (HP:0000252): Head circumference below 2 standard deviations below the mean for age and gender. Evidence: TAS. Frequency: Very frequent (HP:0040281). (ORPHA:1270)
- Sloping forehead (HP:0000340): Inclination of the anterior surface of the forehead from the vertical more than two standard deviations above the mean (objective); or apparently excessive posterior sloping of the forehead in a lateral view. Evidence: TAS. Frequency: Very frequent (HP:0040281). (ORPHA:1270)
- Micrognathia (HP:0000347): Developmental hypoplasia of the mandible. Evidence: TAS. Frequency: Very frequent (HP:0040281). (ORPHA:1270)
- Prominent nose (HP:0000448): Distance between subnasale and pronasale more than two standard deviations above the mean, or alternatively, an apparently increased anterior protrusion of the nasal tip. Evidence: TAS. Frequency: Very frequent (HP:0040281). (ORPHA:1270)
- Joint stiffness (HP:0001387): Joint stiffness is a perceived sensation of tightness in a joint or joints when attempting to move them after a period of inactivity. Joint stiffness typically subsides over time. Evidence: TAS. Frequency: Very frequent (HP:0040281). (ORPHA:1270)
- Death in infancy (HP:0001522): Death within the first 24 months of life. Evidence: TAS. Frequency: Very frequent (HP:0040281). (ORPHA:1270)
- Short stature (HP:0004322): A height below that which is expected according to age and gender norms. Although there is no universally accepted definition of short stature, many refer to "short stature" as height more than 2 standard deviations below the mean for age and gender (or below the 3rd percentile for age and gender dependent norms). Evidence: TAS. Frequency: Very frequent (HP:0040281). (ORPHA:1270)
- Severe postnatal growth retardation (HP:0008850): Severely slow or limited growth after birth, being four standard deviations or more below age- and sex-related norms. Evidence: TAS. Frequency: Very frequent (HP:0040281). (ORPHA:1270)
- Feeding difficulties in infancy (HP:0008872): Impaired feeding performance of an infant as manifested by difficulties such as weak and ineffective sucking, brief bursts of sucking, and falling asleep during sucking. There may be difficulties with chewing or maintaining attention. Evidence: TAS. Frequency: Very frequent (HP:0040281). (ORPHA:1270)
- Severe global developmental delay (HP:0011344): A severe delay in the achievement of motor or mental milestones in the domains of development of a child. Evidence: TAS. Frequency: Very frequent (HP:0040281). (ORPHA:1270)
- Cryptorchidism (HP:0000028): Testis in inguinal canal. That is, absence of one or both testes from the scrotum owing to failure of the testis or testes to descend through the inguinal canal to the scrotum. Evidence: TAS. Frequency: Frequent (HP:0040282). (ORPHA:1270)
- Rocker bottom foot (HP:0001838): The presence of both a prominent heel and a convex contour of the sole. Evidence: TAS. Frequency: Frequent (HP:0040282). (ORPHA:1270)
- Clinodactyly of the 5th finger (HP:0004209): Clinodactyly refers to a bending or curvature of the fifth finger in the radial direction (i.e., towards the 4th finger). Evidence: TAS. Frequency: Frequent (HP:0040282). (ORPHA:1270)
- Severe intrauterine growth retardation (HP:0008846): Intrauterine growth retardation that is 4 or more standard deviations below average, corrected for sex and gestational age. Evidence: TAS. Frequency: Frequent (HP:0040282). (ORPHA:1270)
- Camptodactyly of finger (HP:0100490): The distal interphalangeal joint and/or the proximal interphalangeal joint of the fingers cannot be extended to 180 degrees by either active or passive extension. Evidence: TAS. Frequency: Frequent (HP:0040282). (ORPHA:1270)
- Orofacial cleft (HP:0000202): The presence of a cleft (gap, opening, or groove) in the oral cavity, including cleft of the upper lip and/or cleft of the palate. Cleft of the upper lip is visible as a groove or fissure in the lip, most frequently due to a congenital failure of the maxillary and median nasal processes to fuse. Cleft palate is characterized by a grooved depression or fissure in the roof of the mouth, most often resulting from a congenital failure of the palate to fuse properly. Clefts of the lip and palate can occur individually or together. It is preferable to code each defect separately. Evidence: TAS. Frequency: Occasional (HP:0040283). (ORPHA:1270)
- Seizure (HP:0001250): A seizure is an intermittent abnormality of nervous system physiology characterized by a transient occurrence of signs and/or symptoms due to abnormal excessive or synchronous neuronal activity in the brain. Evidence: TAS. Frequency: Occasional (HP:0040283). (ORPHA:1270)
- Abnormal lung lobation (HP:0002101): A developmental defect in the formation of pulmonary lobes. Evidence: TAS. Frequency: Occasional (HP:0040283). (ORPHA:1270)
- Ventriculomegaly (HP:0002119): An increase in size of the ventricular system of the brain. Evidence: TAS. Frequency: Occasional (HP:0040283). (ORPHA:1270)
- Abnormal cardiovascular system morphology (HP:0030680): Any structural anomaly of the heart and blood vessels. Evidence: TAS. Frequency: Occasional (HP:0040283). (ORPHA:1270)
These phenotypes are associated with the disease Bowen-Conradi syndrome (ORPHA:1270).